- Hypersensitivity pneumonitis (HP:0006516): Hypersensitivity pneumonitis involves inhalation of an antigen. This leads to an exaggerated immune response and a following inflammation of the alveoli within the lungs. The main feature of chronic hypersensitivity pneumonitis on lung biopsies is expansion of the interstitium by lymphocytes accompanied by an occasional multinucleated giant cell or loose granuloma. After exposure to the provoking antigen, following symptoms can be seen: fever, chills, malaise, cough, hemoptysis, chest tightness, dyspnea, rash, swelling and headache and can be completely reversible, based on the duration of the illness, categorized as acute (HP:0011009), subacute (HP:0011011), and chronic (HP:0011010). Evidence: IEA. (OMIM:145300)
- Autosomal dominant inheritance (HP:0000006): A mode of inheritance that is observed for traits related to a gene encoded on one of the autosomes (i.e., the human chromosomes 1-22) in which a trait manifests in heterozygotes. In the context of medical genetics, an autosomal dominant disorder is caused when a single copy of the mutant allele is present. Males and females are affected equally, and can both transmit the disorder with a risk of 50% for each child of inheriting the mutant allele. Evidence: IEA. (OMIM:145300)
These phenotypes are associated with the disease hypersensitivity pneumonitis, familial (OMIM:145300).